Phenotypes associated with the disease antithrombin, familial hemorrhagic diathesis due to (OMIM:207300):
- Abnormal bleeding (HP:0001892): An abnormal susceptibility to bleeding, often referred to as a bleeding diathesis. A bleeding diathesis may be related to vascular, platelet and coagulation defects. Evidence: TAS. (OMIM:207300)
- Autosomal recessive inheritance (HP:0000007): A mode of inheritance that is observed for traits related to a gene encoded on one of the autosomes (i.e., the human chromosomes 1-22) in which a trait manifests in individuals with two pathogenic alleles, either homozygotes (two copies of the same mutant allele) or compound heterozygotes (whereby each copy of a gene has a distinct mutant allele). Evidence: TAS. (OMIM:207300)